- Portal hypertension (HP:0001409): Increased pressure in the portal vein. Evidence: IEA. (PMID:12417987)
- Autosomal recessive inheritance (HP:0000007): A mode of inheritance that is observed for traits related to a gene encoded on one of the autosomes (i.e., the human chromosomes 1-22) in which a trait manifests in individuals with two pathogenic alleles, either homozygotes (two copies of the same mutant allele) or compound heterozygotes (whereby each copy of a gene has a distinct mutant allele). Evidence: IEA. (PMID:12417987)
- Biliary cirrhosis (HP:0002613): Progressive destruction of the small-to-medium bile ducts of the intrahepatic biliary tree, which leads to progressive cholestasis and often end-stage liver disease. Evidence: IEA. (PMID:12417987)
- Prolonged neonatal jaundice (HP:0006579): Neonatal jaundice refers to a yellowing of the skin and other tissues of a newborn infant as a result of increased concentrations of bilirubin in the blood. Neonatal jaundice affects over half of all newborns to some extent in the first week of life. Prolonged neonatal jaundice is said to be present if the jaundice persists for longer than 14 days in term infants and 21 days in preterm infants. Evidence: IEA. (PMID:12417987)
These phenotypes are associated with the disease hereditary North American Indian childhood cirrhosis (OMIM:604901).